Phenotypes associated with the disease C1 inhibitor deficiency (OMIM:120790):
- Systemic lupus erythematosus (HP:0002725): A chronic, relapsing, inflammatory, and often febrile multisystemic disorder of connective tissue, characterized principally by involvement of the skin, joints, kidneys, and serosal membranes. Evidence: IEA. (OMIM:120790)
- Autosomal dominant inheritance (HP:0000006): A mode of inheritance that is observed for traits related to a gene encoded on one of the autosomes (i.e., the human chromosomes 1-22) in which a trait manifests in heterozygotes. In the context of medical genetics, an autosomal dominant disorder is caused when a single copy of the mutant allele is present. Males and females are affected equally, and can both transmit the disorder with a risk of 50% for each child of inheriting the mutant allele. Evidence: IEA. (OMIM:120790)